- Preauricular pit (HP:0004467): Small indentation anterior to the insertion of the ear. Evidence: TAS. (OMIM:128700)
- Autosomal dominant inheritance (HP:0000006): A mode of inheritance that is observed for traits related to a gene encoded on one of the autosomes (i.e., the human chromosomes 1-22) in which a trait manifests in heterozygotes. In the context of medical genetics, an autosomal dominant disorder is caused when a single copy of the mutant allele is present. Males and females are affected equally, and can both transmit the disorder with a risk of 50% for each child of inheriting the mutant allele. Evidence: IEA. (OMIM:128700)
These phenotypes are associated with the disease preauricular fistulae, congenital (OMIM:128700).